Phenotypes associated with the disease Schwartz-Jampel syndrome (ORPHA:800):
- Inguinal hernia (HP:0000023): Protrusion of the contents of the abdominal cavity through the inguinal canal. Evidence: TAS. Frequency: Occasional (HP:0040283). (ORPHA:800)
- Abnormality of the ureter (HP:0000069): An abnormality of the ureter. The ureter is the duct by which urine passes from the kidney to the bladder. Evidence: TAS. Frequency: Occasional (HP:0040283). (ORPHA:800)
- Abnormality of the urinary system (HP:0000079): An abnormality of the urinary system. Evidence: TAS. Frequency: Occasional (HP:0040283). (ORPHA:800)
- Narrow mouth (HP:0000160): Distance between the commissures of the mouth more than 2 SD below the mean. Alternatively, an apparently decreased width of the oral aperture (subjective). Evidence: TAS. Frequency: Very frequent (HP:0040281). (ORPHA:800)
- Cleft palate (HP:0000175): Cleft palate is a developmental defect of the palate resulting from a failure of fusion of the palatine processes and manifesting as a separation of the roof of the mouth (soft and hard palate). Evidence: TAS. Frequency: Occasional (HP:0040283). (ORPHA:800)
- Pursed lips (HP:0000205): An abnormality of the appearance of the face caused by constant contraction of the lips leading to a puckered or pursed appearance. Evidence: TAS. Frequency: Very frequent (HP:0040281). (ORPHA:800)
- Trismus (HP:0000211): Limitation in the ability to open the mouth. Evidence: TAS. Frequency: Very frequent (HP:0040281). (ORPHA:800)
- High palate (HP:0000218): Height of the palate more than 2 SD above the mean (objective) or palatal height at the level of the first permanent molar more than twice the height of the teeth (subjective). Evidence: TAS. Frequency: Frequent (HP:0040282). (ORPHA:800)
- Everted lower lip vermilion (HP:0000232): An abnormal configuration of the lower lip such that it is turned outward i.e., everted, with the Inner aspect of the lower lip vermilion (normally opposing the teeth) being visible in a frontal view. Evidence: TAS. Frequency: Very frequent (HP:0040281). (ORPHA:800)
- Microcephaly (HP:0000252): Head circumference below 2 standard deviations below the mean for age and gender. Evidence: TAS. Frequency: Occasional (HP:0040283). (ORPHA:800)
- Full cheeks (HP:0000293): Increased prominence or roundness of soft tissues between zygomata and mandible. Evidence: TAS. Frequency: Very frequent (HP:0040281). (ORPHA:800)
- Low anterior hairline (HP:0000294): Distance between the hairline (trichion) and the glabella (the most prominent point on the frontal bone above the root of the nose), in the midline, more than two SD below the mean. Alternatively, an apparently decreased distance between the hairline and the glabella. Evidence: TAS. Frequency: Occasional (HP:0040283). (ORPHA:800)
- Mask-like facies (HP:0000298): A lack of facial expression often with staring eyes and a slightly open mouth. Evidence: TAS. Frequency: Frequent (HP:0040282). (ORPHA:800)
- Hypertelorism (HP:0000316): Interpupillary distance more than 2 SD above the mean (alternatively, the appearance of an increased interpupillary distance or widely spaced eyes). Evidence: TAS. Frequency: Occasional (HP:0040283). (ORPHA:800)
- Long philtrum (HP:0000343): Distance between nasal base and midline upper lip vermilion border more than 2 SD above the mean. Alternatively, an apparently increased distance between nasal base and midline upper lip vermilion border. Evidence: TAS. Frequency: Occasional (HP:0040283). (ORPHA:800)
- Micrognathia (HP:0000347): Developmental hypoplasia of the mandible. Evidence: TAS. Frequency: Frequent (HP:0040282). (ORPHA:800)
- Overfolded helix (HP:0000396): A condition in which the helix is folded over to a greater degree than normal. That is, excessive curling of the helix edge, whereby the free edge is parallel to the plane of the ear. Evidence: TAS. Frequency: Frequent (HP:0040282). (ORPHA:800)
- Prominent nasal bridge (HP:0000426): Anterior positioning of the nasal root in comparison to the usual positioning for age. Evidence: TAS. Frequency: Frequent (HP:0040282). (ORPHA:800)
- Short neck (HP:0000470): Diminished length of the neck. Evidence: TAS. Frequency: Frequent (HP:0040282). (ORPHA:800)
- Microcornea (HP:0000482): A congenital abnormality of the cornea in which the cornea and the anterior segment of the eye are smaller than normal. The horizontal diameter of the cornea does not reach 10 mm even in adulthood. Evidence: TAS. Frequency: Occasional (HP:0040283). (ORPHA:800)
- Strabismus (HP:0000486): A misalignment of the eyes so that the visual axes deviate from bifoveal fixation. The classification of strabismus may be based on a number of features including the relative position of the eyes, whether the deviation is latent or manifest, intermittent or constant, concomitant or otherwise and according to the age of onset and the relevance of any associated refractive error. Evidence: TAS. Frequency: Frequent (HP:0040282). (ORPHA:800)
- Visual impairment (HP:0000505): Visual impairment (or vision impairment) is vision loss (of a person) to such a degree as to qualify as an additional support need through a significant limitation of visual capability resulting from either disease, trauma, or congenital or degenerative conditions that cannot be corrected by conventional means, such as refractive correction, medication, or surgery. Evidence: TAS. Frequency: Very frequent (HP:0040281). (ORPHA:800)
- Ptosis (HP:0000508): The upper eyelid margin is positioned 3 mm or more lower than usual and covers the superior portion of the iris (objective); or, the upper lid margin obscures at least part of the pupil (subjective). Evidence: TAS. Frequency: Frequent (HP:0040282). (ORPHA:800)
- Cataract (HP:0000518): A cataract is an opacity or clouding that develops in the crystalline lens of the eye or in its capsule. Evidence: TAS. Frequency: Frequent (HP:0040282). (ORPHA:800)
- Abnormal eyebrow morphology (HP:0000534): An abnormality of the eyebrow. Evidence: TAS. Frequency: Frequent (HP:0040282). (ORPHA:800)
- Myopia (HP:0000545): An abnormality of refraction characterized by the ability to see objects nearby clearly, while objects in the distance appear blurry. Evidence: TAS. Frequency: Frequent (HP:0040282). (ORPHA:800)
- Blepharophimosis (HP:0000581): A fixed reduction in the vertical distance between the upper and lower eyelids with short palpebral fissures. Evidence: TAS. Frequency: Frequent (HP:0040282). (ORPHA:800)
- Abnormality of the pharynx (HP:0000600): An anomaly of the pharynx, i.e., of the tubular structure extending from the base of the skull superiorly to the esophageal inlet inferiorly. Evidence: TAS. Frequency: Frequent (HP:0040282). (ORPHA:800)
- Blepharospasm (HP:0000643): A focal dystonia that affects the muscles of the eyelids and brow, associated with involuntary recurrent spasm of both eyelids. Evidence: TAS. Frequency: Occasional (HP:0040283). (ORPHA:800)
- Dental malocclusion (HP:0000689): Dental malocclusion refers to an abnormality of the occlusion, or alignment, of the teeth and the way the upper and lower teeth fit together, resulting in overcrowding of teeth or in abnormal bite patterns. Evidence: TAS. Frequency: Occasional (HP:0040283). (ORPHA:800)
- Irritability (HP:0000737): An emotional state characterized by negative feelings of heightened frustration, annoyance, or feeling upset, often triggered by internal factors (e.g., fatigue, hunger, unfulfilled desires) or external factors (e.g., social or environmental challenges). Irritability may be unpredictable, and is accompanied by a lowered threshold for emotional reactivity and observable features (speech, facial expressions, or psychomotor activity). Evidence: TAS. Frequency: Occasional (HP:0040283). (ORPHA:800)
- Anxiety (HP:0000739): Intense feelings of nervousness, tension, or panic often arise in response to interpersonal stresses. There is worry about the negative effects of past unpleasant experiences and future negative possibilities. Individuals may feel fearful, apprehensive, or threatened by uncertainty, and they may also have fears of falling apart or losing control. Evidence: TAS. Frequency: Occasional (HP:0040283). (ORPHA:800)
- Pectus excavatum (HP:0000767): A defect of the chest wall characterized by a depression of the sternum, giving the chest ("pectus") a caved-in ("excavatum") appearance. Evidence: TAS. Frequency: Occasional (HP:0040283). (ORPHA:800)
- Pectus carinatum (HP:0000768): A deformity of the chest caused by overgrowth of the ribs and characterized by protrusion of the sternum. Evidence: TAS. Frequency: Frequent (HP:0040282). (ORPHA:800)
- Abnormal rib morphology (HP:0000772): An anomaly of the rib. Evidence: TAS. Frequency: Occasional (HP:0040283). (ORPHA:800)
- Kidney stone (HP:0000787): Kidney stones (calculi) are mineral concretions in the renal calyces and pelvis that are found free or attached to the renal papillae. Evidence: TAS. Frequency: Occasional (HP:0040283). (ORPHA:800)
- Sprengel anomaly (HP:0000912): A congenital skeletal deformity characterized by the elevation of one scapula (thus, one scapula is located superior to the other). Evidence: TAS. Frequency: Occasional (HP:0040283). (ORPHA:800)
- Platyspondyly (HP:0000926): A flattened vertebral body shape with reduced distance between the vertebral endplates. Evidence: TAS. Frequency: Frequent (HP:0040282). (ORPHA:800)
- Osteoporosis (HP:0000939): Osteoporosis is a systemic skeletal disease characterized by low bone density and microarchitectural deterioration of bone tissue with a consequent increase in bone fragility. According to the WHO criteria, osteoporosis is defined as a BMD that lies 2.5 standard deviations or more below the average value for young healthy adults (a T-score below -2.5 SD). Evidence: TAS. Frequency: Frequent (HP:0040282). (ORPHA:800)
- Abnormal metaphysis morphology (HP:0000944): An abnormality of one or more metaphysis, i.e., of the somewhat wider portion of a long bone that is adjacent to the epiphyseal growth plate and grows during childhood. Evidence: TAS. Frequency: Very frequent (HP:0040281). (ORPHA:800)
- Ectopia lentis (HP:0001083): Dislocation or malposition of the crystalline lens of the eye. A partial displacement (or dislocation) of the lens is described as a subluxation of the lens, while a complete displacement is termed luxation of the lens. A complete displacement occurs if the lens is completely outside the patellar fossa of the lens, either in the anterior chamber, in the vitreous, or directly on the retina. If the lens is partially displaced but still contained within the lens space, then it is termed subluxation. Evidence: TAS. Frequency: Occasional (HP:0040283). (ORPHA:800)
- Wrist flexion contracture (HP:0001239): A chronic loss of wrist joint motion due to structural changes in muscle, tendons, ligaments, or skin that prevent normal movement of the joints of the wrist. Evidence: TAS. Frequency: Frequent (HP:0040282). (ORPHA:800)
- Intellectual disability (HP:0001249): The term intellectual disability or intellectual developmental disorder is used to describe significantly sub-average intellectual and adaptive functioning based on clinical assessment and as measured by individually administered, appropriately normed, standardized and validated tests of intellectual functioning and adaptive behavior, with onset during the developmental period from infancy through adolescence. Evidence: TAS. Frequency: Very frequent (HP:0040281). (ORPHA:800)
- Hyporeflexia (HP:0001265): Reduction of neurologic reflexes such as the knee-jerk reaction. Evidence: TAS. Frequency: Frequent (HP:0040282). (ORPHA:800)
- Hypertonia (HP:0001276): A condition in which there is increased muscle tone so that arms or legs, for example, are stiff and difficult to move. Evidence: TAS. Frequency: Very frequent (HP:0040281). (ORPHA:800)
- Gait disturbance (HP:0001288): The term gait disturbance can refer to any disruption of the ability to walk. Evidence: TAS. Frequency: Very frequent (HP:0040281). (ORPHA:800)
- Muscle weakness (HP:0001324): Reduced strength of muscles. Evidence: TAS. Frequency: Occasional (HP:0040283). (ORPHA:800)
- Hip dysplasia (HP:0001385): The presence of developmental dysplasia of the hip. Evidence: TAS. Frequency: Very frequent (HP:0040281). (ORPHA:800)
- Joint stiffness (HP:0001387): Joint stiffness is a perceived sensation of tightness in a joint or joints when attempting to move them after a period of inactivity. Joint stiffness typically subsides over time. Evidence: TAS. Frequency: Very frequent (HP:0040281). (ORPHA:800)
- Death in infancy (HP:0001522): Death within the first 24 months of life. Evidence: TAS. Frequency: Occasional (HP:0040283). (ORPHA:800)
- Umbilical hernia (HP:0001537): Protrusion of abdominal contents through a defect in the abdominal wall musculature around the umbilicus. Skin and subcutaneous tissue overlie the defect. Evidence: TAS. Frequency: Occasional (HP:0040283). (ORPHA:800)
- Prenatal movement abnormality (HP:0001557): An abnormality of fetal movement. Evidence: TAS. Frequency: Occasional (HP:0040283). (ORPHA:800)
- Polyhydramnios (HP:0001561): The presence of excess amniotic fluid in the uterus during pregnancy. Evidence: TAS. Frequency: Occasional (HP:0040283). (ORPHA:800)
- Laryngomalacia (HP:0001601): Laryngomalacia is a congenital abnormality of the laryngeal cartilage in which the cartilage is floppy and prolapses over the larynx during inspiration. Evidence: TAS. Frequency: Occasional (HP:0040283). (ORPHA:800)
- Dysphonia (HP:0001618): Difficulty in speaking due to a physical disorder of the mouth, tongue, throat, or vocal cords. Associated with a known physical or neurological cause. Evidence: TAS. Frequency: Occasional (HP:0040283). (ORPHA:800)
- Abnormally high-pitched voice (HP:0001620): A persistent (minutes to hours) abnormal increase in the pitch (frequency) of the voice for the context or social situation or significantly different from baseline of the individual. Evidence: TAS. Frequency: Frequent (HP:0040282). (ORPHA:800)
- Weak voice (HP:0001621): Reduced intensity (volume) of speech. Evidence: TAS. Frequency: Frequent (HP:0040282). (ORPHA:800)
- Talipes equinovarus (HP:0001762): Talipes equinovarus (also called clubfoot) typically has four main components: inversion and adduction of the forefoot; inversion of the heel and hindfoot; equinus (limitation of extension) of the ankle and subtalar joint; and internal rotation of the leg. Evidence: TAS. Frequency: Occasional (HP:0040283). (ORPHA:800)
- Pes planus (HP:0001763): A foot where the longitudinal arch of the foot is in contact with the ground or floor when the individual is standing; or, in a patient lying supine, a foot where the arch is in contact with the surface of a flat board pressed against the sole of the foot by the examiner with a pressure similar to that expected from weight bearing; or, the height of the arch is reduced. Evidence: TAS. Frequency: Very frequent (HP:0040281). (ORPHA:800)
- Malignant hyperthermia (HP:0002047): Malignant hyperthermia is characterized by a rapid increase in temperature to 39-42 degrees C. Malignant hyperthermia may occur in response to either inhalational anesthetics such as halothane, to muscle relaxants such as succinylcholine, or to exercise. Evidence: TAS. Frequency: Occasional (HP:0040283). (ORPHA:800)
- Pulmonary arterial hypertension (HP:0002092): Pulmonary hypertension is defined mean pulmonary artery pressure of 25mmHg or more and pulmonary capillary wedge pressure of 15mmHg or less when measured by right heart catheterisation at rest and in a supine position. Evidence: TAS. Frequency: Occasional (HP:0040283). (ORPHA:800)
- Respiratory insufficiency (HP:0002093). Evidence: TAS. Frequency: Occasional (HP:0040283). (ORPHA:800)
- Apnea (HP:0002104): Lack of breathing with no movement of the respiratory muscles and no exchange of air in the lungs. This term refers to a disposition to have recurrent episodes of apnea rather than to a single event. Evidence: TAS. Frequency: Occasional (HP:0040283). (ORPHA:800)
- Abnormal speech pattern (HP:0002167): An abnormality in the sound (volume) or cadence (rate) of speech. Evidence: TAS. Frequency: Occasional (HP:0040283). (ORPHA:800)
- Generalized hirsutism (HP:0002230): Abnormally increased hair growth over much of the entire body. Evidence: TAS. Frequency: Occasional (HP:0040283). (ORPHA:800)
- Myotonia (HP:0002486): An involuntary and painless delay in the relaxation of skeletal muscle following contraction or electrical stimulation. Evidence: TAS. Frequency: Very frequent (HP:0040281). (ORPHA:800)
- Wormian bones (HP:0002645): The presence of extra bones within a cranial suture. Wormian bones are irregular isolated bones which appear in addition to the usual centers of ossification of the cranium. Evidence: TAS. Frequency: Occasional (HP:0040283). (ORPHA:800)
- Scoliosis (HP:0002650): The presence of an abnormal lateral curvature of the spine. Evidence: TAS. Frequency: Frequent (HP:0040282). (ORPHA:800)
- Skeletal dysplasia (HP:0002652): A general term describing features characterized by abnormal development of bones and connective tissues. Evidence: TAS. Frequency: Very frequent (HP:0040281). (ORPHA:800)
- Coxa valga (HP:0002673): Coxa valga is a deformity of the hip in which the angle between the femoral shaft and the femoral neck is increased compared to age-adjusted values (about 150 degrees in newborns gradually reducing to 120-130 degrees in adults). Evidence: TAS. Frequency: Frequent (HP:0040282). (ORPHA:800)
- Delayed skeletal maturation (HP:0002750): A decreased rate of skeletal maturation. Delayed skeletal maturation can be diagnosed on the basis of an estimation of the bone age from radiographs of specific bones in the human body. Evidence: TAS. Frequency: Occasional (HP:0040283). (ORPHA:800)
- Arthrogryposis multiplex congenita (HP:0002804): Multiple congenital contractures in different body areas. Evidence: TAS. Frequency: Very frequent (HP:0040281). (ORPHA:800)
- Kyphosis (HP:0002808): Exaggerated anterior convexity of the thoracic vertebral column. Evidence: TAS. Frequency: Frequent (HP:0040282). (ORPHA:800)
- Coxa vara (HP:0002812): Coxa vara includes all forms of decrease of the femoral neck shaft angle (the angle between the neck and the shaft of the femur) to less than 120 degrees. Evidence: TAS. Frequency: Frequent (HP:0040282). (ORPHA:800)
- Genu valgum (HP:0002857): The legs angle inward, such that the knees are close together and the ankles far apart. Evidence: TAS. Frequency: Very frequent (HP:0040281). (ORPHA:800)
- Micromelia (HP:0002983): The presence of abnormally small extremities. Evidence: TAS. Frequency: Very frequent (HP:0040281). (ORPHA:800)
- Elbow dislocation (HP:0003042): Dislocation of the distal humerus out of the elbow joint, where the radius, ulna, and humerus meet. Evidence: TAS. Frequency: Occasional (HP:0040283). (ORPHA:800)
- Shoulder flexion contracture (HP:0003044): Chronic reduction in active and passive mobility of the shoulder joint due to structural changes in muscle, tendons, ligaments, or skin that prevents normal movement. Evidence: TAS. Frequency: Frequent (HP:0040282). (ORPHA:800)
- Protrusio acetabuli (HP:0003179): Intrapelvic bulging of the medial acetabular wall. Evidence: TAS. Frequency: Occasional (HP:0040283). (ORPHA:800)
- Myopathy (HP:0003198): A disorder of muscle unrelated to impairment of innervation or neuromuscular junction. Evidence: TAS. Frequency: Frequent (HP:0040282). (ORPHA:800)
- Skeletal muscle atrophy (HP:0003202): The presence of skeletal muscular atrophy (which is also known as amyotrophy). Evidence: TAS. Frequency: Occasional (HP:0040283). (ORPHA:800)
- Elevated circulating creatine kinase activity (HP:0003236): The activity of creatine kinase in the blood circulation is above the upper limit of normal. Evidence: TAS. Frequency: Very frequent (HP:0040281). (ORPHA:800)
- Hip contracture (HP:0003273): Lack of full passive range of motion (restrictions in flexion, extension, or other movements) of the hip joint resulting from structural changes of non-bony tissues, such as muscles, tendons, ligaments, joint capsules and/or skin. Evidence: TAS. Frequency: Frequent (HP:0040282). (ORPHA:800)
- Spinal rigidity (HP:0003306): Reduced ability to move the vertebral column with a resulting limitation of neck and trunk flexion. Evidence: TAS. Frequency: Frequent (HP:0040282). (ORPHA:800)
- Hyperlordosis (HP:0003307): Abnormally increased curvature (anterior concavity) of the lumbar or cervical spine. Evidence: TAS. Frequency: Frequent (HP:0040282). (ORPHA:800)
- Myalgia (HP:0003326): Pain in muscle. Evidence: TAS. Frequency: Occasional (HP:0040283). (ORPHA:800)
- EMG abnormality (HP:0003457): Abnormal results of investigations using electromyography (EMG). Evidence: TAS. Frequency: Very frequent (HP:0040281). (ORPHA:800)
- Skeletal muscle hypertrophy (HP:0003712): Abnormal increase in muscle size and mass not due to training. Evidence: TAS. Frequency: Frequent (HP:0040282). (ORPHA:800)
- Short stature (HP:0004322): A height below that which is expected according to age and gender norms. Although there is no universally accepted definition of short stature, many refer to "short stature" as height more than 2 standard deviations below the mean for age and gender (or below the 3rd percentile for age and gender dependent norms). Evidence: TAS. Frequency: Very frequent (HP:0040281). (ORPHA:800)
- Decreased body weight (HP:0004325): Abnormally low body weight. Evidence: TAS. Frequency: Occasional (HP:0040283). (ORPHA:800)
- Cachexia (HP:0004326): Severe weight loss, wasting of muscle, loss of appetite, and general debility related to a chronic disease. Evidence: TAS. Frequency: Occasional (HP:0040283). (ORPHA:800)
- Flexion contracture of toe (HP:0005830): One or more bent (flexed) toe joints that cannot be straightened actively or passively. Evidence: TAS. Frequency: Frequent (HP:0040282). (ORPHA:800)
- Abnormal epiphysis morphology (HP:0005930): An anomaly of epiphysis, which is the expanded articular end of a long bone that developes from a secondary ossification center, and which during the period of growth is either entirely cartilaginous or is separated from the shaft by a cartilaginous disk. Evidence: TAS. Frequency: Very frequent (HP:0040281). (ORPHA:800)
- Bowing of the long bones (HP:0006487): A bending or abnormal curvature of a long bone. Evidence: TAS. Frequency: Very frequent (HP:0040281). (ORPHA:800)
- Attention deficit hyperactivity disorder (HP:0007018): Attention deficit hyperactivity disorder (ADHD) manifests at age 2-3 years or by first grade at the latest. The main symptoms are distractibility, impulsivity, hyperactivity, and often trouble organizing tasks and projects, difficulty going to sleep, and social problems from being aggressive, loud, or impatient. Evidence: TAS. Frequency: Occasional (HP:0040283). (ORPHA:800)
- Long eyelashes in irregular rows (HP:0007740). Evidence: TAS. Frequency: Occasional (HP:0040283). (ORPHA:800)
- Aplasia/Hypoplasia affecting the eye (HP:0008056). Evidence: TAS. Frequency: Occasional (HP:0040283). (ORPHA:800)
- Decreased testicular size (HP:0008734): Reduced volume of the testicle (the male gonad). Evidence: TAS. Frequency: Occasional (HP:0040283). (ORPHA:800)
- Feeding difficulties in infancy (HP:0008872): Impaired feeding performance of an infant as manifested by difficulties such as weak and ineffective sucking, brief bursts of sucking, and falling asleep during sucking. There may be difficulties with chewing or maintaining attention. Evidence: TAS. Frequency: Occasional (HP:0040283). (ORPHA:800)
- Distichiasis (HP:0009743): Double rows of eyelashes. Evidence: TAS. Frequency: Occasional (HP:0040283). (ORPHA:800)
- Metatarsus valgus (HP:0010508): A condition in which the anterior part of the foot rotates outward away from the midline of the body and the heel remains straight. Evidence: TAS. Frequency: Very frequent (HP:0040281). (ORPHA:800)
- Abnormality of immune system physiology (HP:0010978): A functional abnormality of the immune system. Evidence: TAS. Frequency: Occasional (HP:0040283). (ORPHA:800)
- Increased bone mineral density (HP:0011001): An abnormal increase of bone mineral density, that is, of the amount of matter per cubic centimeter of bones which is often referred to as osteosclerosis. Osteosclerosis can be detected on radiological examination as an increased whiteness (density) of affected bones. Evidence: TAS. Frequency: Occasional (HP:0040283). (ORPHA:800)
- Supernumerary tooth (HP:0011069): The presence of one or more teeth additional to the normal number. Evidence: TAS. Frequency: Occasional (HP:0040283). (ORPHA:800)
- Arrhythmia (HP:0011675): Any cardiac rhythm other than the normal sinus rhythm. Such a rhythm may be either of sinus or ectopic origin and either regular or irregular. An arrhythmia may be due to a disturbance in impulse formation or conduction or both. Evidence: TAS. Frequency: Occasional (HP:0040283). (ORPHA:800)
- Flat face (HP:0012368): Absence of concavity or convexity of the face when viewed in profile. Evidence: TAS. Frequency: Frequent (HP:0040282). (ORPHA:800)
- Elevated circulating aldolase concentration (HP:0012544): Concentration of fructose 1,6-bisphosphate aldolase in the blood circulation above the upper limit of normal. Evidence: TAS. Frequency: Very frequent (HP:0040281). (ORPHA:800)
- Abnormally ossified vertebrae (HP:0100569): An abnormality of the formation and mineralization of one or more vertebrae. Evidence: TAS. Frequency: Frequent (HP:0040282). (ORPHA:800)
- Odontogenic neoplasm (HP:0100612): Neoplasm involving odontogenic cells, an odontogenic tumor. Evidence: TAS. Frequency: Occasional (HP:0040283). (ORPHA:800)
- Abnormally straight spine (HP:0100795): The absence of the normal curvature of the vertebral column. Evidence: TAS. Frequency: Occasional (HP:0040283). (ORPHA:800)
- Testicular torsion (HP:0100813): Testicular torsion is when the spermatic cord to a testicle twists, cutting off the blood supply. The most common symptom is acute testicular pain. Evidence: TAS. Frequency: Occasional (HP:0040283). (ORPHA:800)
- Posteriorly rotated ears (HP:0000358): A type of abnormal location of the ears in which the position of the ears is characterized by posterior rotation (the superior part of the ears is rotated towards the back of the head, and the inferior part of the ears towards the front). Evidence: TAS. Frequency: Very frequent (HP:0040281). (ORPHA:800)